Phenotypes associated with the disease specific language impairment 1 (OMIM:606711):
- Delayed speech and language development (HP:0000750): A degree of language development that is significantly below the norm for a child of a specified age. Evidence: IEA. (OMIM:606711)
- Language impairment (HP:0002463): Language impairment is a deficit in comprehension or production of language that includes reduced vocabulary, limited sentence structure, or impairments in written or spoken communication. Language abilities are substantially and quantifiably below age expectations. Evidence: TAS. (OMIM:606711)
- Non-Mendelian inheritance (HP:0001426): A mode of inheritance that depends on genetic determinants in more than one gene. Evidence: IEA. (OMIM:606711)
- Deficit in nonword repetition (HP:0002526): Impaired ability to repeat non-word sounds. Nonword repetition (NWR) is a measure of short-term phonological memory. Evidence: IEA. (OMIM:606711)
- Deficit in phonologic short-term memory (HP:0002549): Impaired ability to repeat non-word sounds. The test for nonword repetition involves the repetition of nonsensical words of increasing length and complexity and is regarded as a measure of phonological (speech sound) processing and short-term memory. Evidence: IEA. (OMIM:606711)